Phenotypes associated with the disease extramammary Paget disease (OMIM:167300):
- Neoplasm (HP:0002664): An organ or organ-system abnormality that consists of uncontrolled autonomous cell-proliferation which can occur in any part of the body as a benign or malignant neoplasm (tumor). Evidence: IEA. (OMIM:167300)
- Eczematoid dermatitis (HP:0000964): Eczema is a form of dermatitis that is characterized by scaly, pruritic, erythematous lesions located on flexural surfaces. Evidence: TAS. (OMIM:167300)